- Ventricular septal defect (HP:0001629): A hole between the two bottom chambers (ventricles) of the heart. The defect is centered around the most superior aspect of the ventricular septum. Evidence: IEA. (OMIM:178370)
- Pulmonary artery atresia (HP:0004935): A congenital anomaly with a narrowing or complete absence of the opening between the right ventricle and the pulmonary artery. Evidence: IEA. (OMIM:178370)
- Autosomal dominant inheritance (HP:0000006): A mode of inheritance that is observed for traits related to a gene encoded on one of the autosomes (i.e., the human chromosomes 1-22) in which a trait manifests in heterozygotes. In the context of medical genetics, an autosomal dominant disorder is caused when a single copy of the mutant allele is present. Males and females are affected equally, and can both transmit the disorder with a risk of 50% for each child of inheriting the mutant allele. Evidence: IEA. (OMIM:178370)
These phenotypes are associated with the disease pulmonary atresia with ventricular septal defect (OMIM:178370).